Phenotypes associated with the disease peeling skin syndrome 5 (OMIM:617115):
- Scaling skin (HP:0040189): Refers to the loss of the outer layer of the epidermis in large, scale-like flakes. Evidence: PCS. Frequency: 7/7. (PMID:27476651)
- Infantile onset (HP:0003593): Onset of signs or symptoms of disease between 28 days to one year of life. Evidence: PCS. Frequency: 7/7. (PMID:27476651)
- Epidermal acanthosis (HP:0025092): Diffuse hypertrophy or thickening of the stratum spinosum of the epidermis (prickle cell layer of the skin). Evidence: PCS. (PMID:27476651)
- Autosomal recessive inheritance (HP:0000007): A mode of inheritance that is observed for traits related to a gene encoded on one of the autosomes (i.e., the human chromosomes 1-22) in which a trait manifests in individuals with two pathogenic alleles, either homozygotes (two copies of the same mutant allele) or compound heterozygotes (whereby each copy of a gene has a distinct mutant allele). Evidence: PCS. (PMID:27476651)
- Hyperkeratosis (HP:0000962): Hyperkeratosis is a histopathological term defining a thickened stratum corneum and may be present in many different skin conditions, with many possible overlaps. Hyperkeratosis refers to the increased thickness of the stratum corneum, the outer layer of the skin. Hyperkeratosis is subclassified as orthokeratotic or parakeratotic. Orthokeratotic hyperkeratosis refers to the thickening of the keratin layer with preserved keratinocyte maturation, while parakeratotic hyperkeratosis shows retained nuclei as a sign of delayed maturation of keratinocytes. Evidence: PCS. (PMID:27476651)